Phenotypes associated with the disease Congenital varicella syndrome (ORPHA:291):
- Microcephaly (HP:0000252): Head circumference below 2 standard deviations below the mean for age and gender. Evidence: TAS. Frequency: Frequent (HP:0040282). (ORPHA:291)
- Cataract (HP:0000518): A cataract is an opacity or clouding that develops in the crystalline lens of the eye or in its capsule. Evidence: TAS. Frequency: Frequent (HP:0040282). (ORPHA:291)
- Microphthalmia (HP:0000568): A developmental anomaly characterized by abnormal smallness of one or both eyes. Evidence: TAS. Frequency: Frequent (HP:0040282). (ORPHA:291)
- Atypical scarring of skin (HP:0000987): Atypically scarred skin . Evidence: TAS. Frequency: Very frequent (HP:0040281). (ORPHA:291)
- Intellectual disability (HP:0001249): The term intellectual disability or intellectual developmental disorder is used to describe significantly sub-average intellectual and adaptive functioning based on clinical assessment and as measured by individually administered, appropriately normed, standardized and validated tests of intellectual functioning and adaptive behavior, with onset during the developmental period from infancy through adolescence. Evidence: TAS. Frequency: Frequent (HP:0040282). (ORPHA:291)
- Global developmental delay (HP:0001263): A delay in the achievement of motor or mental milestones in the domains of development of a child, including motor skills, speech and language, cognitive skills, and social and emotional skills. This term should only be used to describe children younger than five years of age. Evidence: TAS. Frequency: Frequent (HP:0040282). (ORPHA:291)
- Intrauterine growth retardation (HP:0001511): An abnormal restriction of fetal growth with fetal weight below the tenth percentile for gestational age. Evidence: TAS. Frequency: Very frequent (HP:0040281). (ORPHA:291)
- Cerebral cortical atrophy (HP:0002120): Atrophy of the cortex of the cerebrum. Evidence: TAS. Frequency: Frequent (HP:0040282). (ORPHA:291)
- Micromelia (HP:0002983): The presence of abnormally small extremities. Evidence: TAS. Frequency: Frequent (HP:0040282). (ORPHA:291)